- Constriction of peripheral visual field (HP:0001133): An absolute or relative decrease in retinal sensitivity extending from edge (periphery) of the visual field in a concentric pattern. The visual field is the area that is perceived simultaneously by a fixating eye. Evidence: PCS. Frequency: 2/2. (PMID:33632269)
- Middle age onset (HP:0003596): A type of adult onset with onset of symptoms at the age of 40 to 60 years. Evidence: PCS. Frequency: 2/2. (PMID:33632269)
- Reduced visual acuity (HP:0007663). Evidence: PCS. Frequency: 2/2. (PMID:33632269)
- Optic disc pallor (HP:0000543): A pale yellow discoloration of the optic disc (the area of the optic nerve head in the retina). The optic disc normally has a pinkish hue with a central yellowish depression. Evidence: PCS. Frequency: 2/2. (PMID:33632269)
- Autosomal dominant inheritance (HP:0000006): A mode of inheritance that is observed for traits related to a gene encoded on one of the autosomes (i.e., the human chromosomes 1-22) in which a trait manifests in heterozygotes. In the context of medical genetics, an autosomal dominant disorder is caused when a single copy of the mutant allele is present. Males and females are affected equally, and can both transmit the disorder with a risk of 50% for each child of inheriting the mutant allele. Evidence: PCS. (PMID:33632269)
These phenotypes are associated with the disease optic atrophy 14 (OMIM:620550).